- Sensorineural hearing impairment (HP:0000407): A type of hearing impairment in one or both ears related to an abnormal functionality of the cochlear nerve. Evidence: PCS. (PMID:29408807)
- Autosomal recessive inheritance (HP:0000007): A mode of inheritance that is observed for traits related to a gene encoded on one of the autosomes (i.e., the human chromosomes 1-22) in which a trait manifests in individuals with two pathogenic alleles, either homozygotes (two copies of the same mutant allele) or compound heterozygotes (whereby each copy of a gene has a distinct mutant allele). Evidence: PCS. (PMID:29408807)
These phenotypes are associated with the disease autosomal recessive nonsyndromic hearing loss 26 (OMIM:605428).